Phenotypes associated with the disease 20q11.2 microdeletion syndrome (ORPHA:444051):
- Deeply set eye (HP:0000490): An eye that is more deeply recessed into the plane of the face than is typical. Evidence: TAS. Frequency: Obligate (HP:0040280). (ORPHA:444051)
- Global developmental delay (HP:0001263): A delay in the achievement of motor or mental milestones in the domains of development of a child, including motor skills, speech and language, cognitive skills, and social and emotional skills. This term should only be used to describe children younger than five years of age. Evidence: TAS. Frequency: Obligate (HP:0040280). (ORPHA:444051)
- High forehead (HP:0000348): An abnormally increased height of the forehead. Evidence: TAS. Frequency: Very frequent (HP:0040281). (ORPHA:444051)
- Intrauterine growth retardation (HP:0001511): An abnormal restriction of fetal growth with fetal weight below the tenth percentile for gestational age. Evidence: TAS. Frequency: Very frequent (HP:0040281). (ORPHA:444051)
- Hypertelorism (HP:0000316): Interpupillary distance more than 2 SD above the mean (alternatively, the appearance of an increased interpupillary distance or widely spaced eyes). Evidence: TAS. Frequency: Frequent (HP:0040282). (ORPHA:444051)
- Short philtrum (HP:0000322): Distance between nasal base and midline upper lip vermilion border more than 2 SD below the mean. Alternatively, an apparently decreased distance between nasal base and midline upper lip vermilion border. Evidence: TAS. Frequency: Frequent (HP:0040282). (ORPHA:444051)
- Hearing impairment (HP:0000365): A decreased magnitude of the sensory perception of sound. Evidence: TAS. Frequency: Frequent (HP:0040282). (ORPHA:444051)
- Abnormality of the eye (HP:0000478): Any abnormality of the eye, including location, spacing, and intraocular abnormalities. Evidence: TAS. Frequency: Frequent (HP:0040282). (ORPHA:444051)
- Abnormality of the ear (HP:0000598): An abnormality of the ear. Evidence: TAS. Frequency: Frequent (HP:0040282). (ORPHA:444051)
- Atypical behavior (HP:0000708): Atypical behavior is an abnormality in a person's actions that can be controlled or modulated by the will of the individual. While abnormal behaviors can be difficult to control, they are distinct from other abnormal actions that cannot be affected by the individual's will. Evidence: TAS. Frequency: Frequent (HP:0040282). (ORPHA:444051)
- Hypotonia (HP:0001252): Hypotonia is an abnormally low muscle tone (the amount of tension or resistance to movement in a muscle). Even when relaxed, muscles have a continuous and passive partial contraction which provides some resistance to passive stretching. Hypotonia thus manifests as diminished resistance to passive stretching. Hypotonia is not the same as muscle weakness, although the two conditions can co-exist. Evidence: TAS. Frequency: Frequent (HP:0040282). (ORPHA:444051)
- Talipes calcaneovalgus (HP:0001884): Talipes calcaneovalgus is a flexible foot deformity (as opposed to a rigid congenital vertical talus foot deformity) that can either present as a positional or structural foot deformity depending on severity and/or causality. The axis of calcaneovalgus deformity is in the tibiotalar joint, where the foot is positioned in extreme hyperextension. On inspection, the foot has an "up and out" appearance, with the dorsal forefoot practically touching the anterior aspect of the ankle and lower leg. Evidence: TAS. Frequency: Frequent (HP:0040282). (ORPHA:444051)
- Frontal bossing (HP:0002007): Bilateral bulging of the lateral frontal bone prominences with relative sparing of the midline. Evidence: TAS. Frequency: Frequent (HP:0040282). (ORPHA:444051)
- Brainstem dysplasia (HP:0002508): A developmental structural anomaly of the stalk-like part of the brain that comprises the midbrain (aka mesencephalon), the pons (aka pons Varolii), and the medulla oblongata, and connects the cerebral hemispheres with the cervical spinal cord. Evidence: TAS. Frequency: Frequent (HP:0040282). (ORPHA:444051)
- Midface retrusion (HP:0011800): Posterior positions and/or vertical shortening of the infraorbital and perialar regions, or increased concavity of the face and/or reduced nasolabial angle. Evidence: TAS. Frequency: Frequent (HP:0040282). (ORPHA:444051)
- Camptodactyly (HP:0012385): The distal interphalangeal joint and/or the proximal interphalangeal joint of the fingers or toes cannot be extended to 180 degrees by either active or passive extension. Evidence: TAS. Frequency: Frequent (HP:0040282). (ORPHA:444051)
- Finger clinodactyly (HP:0040019). Evidence: TAS. Frequency: Frequent (HP:0040282). (ORPHA:444051)
- Brachydactyly (HP:0001156): Digits that appear disproportionately short compared to the hand/foot. The word brachydactyly is used here to describe a series distinct patterns of shortened digits (brachydactyly types A-E). This is the sense used here. Evidence: TAS. Frequency: Occasional (HP:0040283). (ORPHA:444051)
- Adducted thumb (HP:0001181): In the resting position, the tip of the thumb is on, or near, the palm, close to the base of the fourth or fifth finger. Evidence: TAS. Frequency: Occasional (HP:0040283). (ORPHA:444051)